Phenotypes associated with the disease long QT syndrome 1 (OMIM:192500):
- Ventricular fibrillation (HP:0001663): Uncontrolled contractions of muscles fibers in the left ventricle not producing contraction of the left ventricle. Ventricular fibrillation usually begins with a ventricular premature contraction and a short run of rapid ventricular tachycardia degenerating into uncoordinating ventricular fibrillations. Evidence: PCS. Frequency: 1/3. (PMID:30008122)
- Hearing abnormality (HP:0000364): An abnormality of the sensory perception of sound. Evidence: PCS. Frequency: 0/6. (PMID:26344792)
- Childhood onset (HP:0011463): Onset of disease at the age of between 1 and 5 years. Evidence: PCS. Frequency: 1/1. (PMID:30008122)
- Prolonged QT interval (HP:0001657): Increased time between the start of the Q wave and the end of the T wave as measured by the electrocardiogram (EKG). Evidence: PCS. (PMID:8528244)
- Prolonged QTc interval (HP:0005184): A longer than normal interval (corrected for heart rate) between the Q and T waves in the heart's cycle. Prolonged QTc can cause premature action potentials during late phase depolarizations thereby leading to ventricular arrhythmias and ventricular fibrillations. Evidence: PCS. Frequency: 5/9. (PMID:30008122;PMID:26344792)
- Syncope (HP:0001279): A transient loss of consciousness (i.e., characterized by a rapid onset, a short duration, and a spontaneous and complete recovery) due to cerebral hypoperfusion. Evidence: PCS. Frequency: 6/9. (PMID:30008122;PMID:26344792)
- Torsade de pointes (HP:0001664): A type of ventricular tachycardia characterized by polymorphioc QRS complexes that change in amplitue and cycle length, and thus have the appearance of oscillating around the baseline in the EKG. Evidence: PCS. Frequency: 1/6. (PMID:26344792)
- Autosomal dominant inheritance (HP:0000006): A mode of inheritance that is observed for traits related to a gene encoded on one of the autosomes (i.e., the human chromosomes 1-22) in which a trait manifests in heterozygotes. In the context of medical genetics, an autosomal dominant disorder is caused when a single copy of the mutant allele is present. Males and females are affected equally, and can both transmit the disorder with a risk of 50% for each child of inheriting the mutant allele. Evidence: PCS. (PMID:8528244)
- Sudden cardiac death (HP:0001645): The heart suddenly and unexpectedly stops beating resulting in death within a short time period (generally within 1 h of symptom onset). Evidence: PCS. Frequency: 1/6. (PMID:26344792)